- Epiblepharon of lower lid (HP:0040151). Evidence: TAS. (OMIM:131450)
- Autosomal dominant inheritance (HP:0000006): A mode of inheritance that is observed for traits related to a gene encoded on one of the autosomes (i.e., the human chromosomes 1-22) in which a trait manifests in heterozygotes. In the context of medical genetics, an autosomal dominant disorder is caused when a single copy of the mutant allele is present. Males and females are affected equally, and can both transmit the disorder with a risk of 50% for each child of inheriting the mutant allele. Evidence: TAS. (OMIM:131450)
These phenotypes are associated with the disease EPIBLEPHARON OF LOWER LID (OMIM:131450).